Phenotypes associated with the disease central incisors, absence of (OMIM:302400):
- Agenesis of central incisor (HP:0006289): Agenesis of one or more central incisors, i.e., of lower secondary incisor, lower primary incisor, upper secondary incisor, or of upper central primary incisor. Evidence: IEA. (OMIM:302400)
- X-linked inheritance (HP:0001417): A mode of inheritance that is observed for traits related to a gene encoded on the X chromosome. Evidence: IEA. (OMIM:302400)